- Typified by somatic mosaicism (HP:0001442): Description of conditions in which affected individuals typically display somatic mosaicism, i.e., genetically distinct populations of somatic cells in a given organism caused by DNA mutations, epigenetic alterations of DNA, chromosomal abnormalities or the spontaneous reversion of inherited mutations. In many conditions typified by somatic mosaicism, constitutive mutation is lethal and cases are exclusively or predominantly mosaic. Evidence: TAS. (OMIM:137800)
- Astrocytoma (HP:0009592): Astrocytoma is a neoplasm of the central nervous system derived from astrocytes. Astrocytes are a type of glial cell, and thus astrocytoma is a subtype of glioma. Evidence: TAS. (OMIM:137800)
- Glioblastoma multiforme (HP:0012174): A tumor arising from glia in the central nervous system with macroscopic regions of necrosis and hemorrhage. Microscopically, glioblastoma multiforme is characterized by regions of pseudopalisading necrosis, pleomorphic nuclei and cells, and microvascular proliferation. Evidence: TAS. (OMIM:137800)
- Ependymoma (HP:0002888): The presence of an ependymoma of the central nervous system. Evidence: TAS. (OMIM:137800)
- Autosomal dominant inheritance (HP:0000006): A mode of inheritance that is observed for traits related to a gene encoded on one of the autosomes (i.e., the human chromosomes 1-22) in which a trait manifests in heterozygotes. In the context of medical genetics, an autosomal dominant disorder is caused when a single copy of the mutant allele is present. Males and females are affected equally, and can both transmit the disorder with a risk of 50% for each child of inheriting the mutant allele. Evidence: TAS. (OMIM:137800)
These phenotypes are associated with the disease glioma susceptibility 1 (OMIM:137800).